- Autosomal recessive inheritance (HP:0000007): A mode of inheritance that is observed for traits related to a gene encoded on one of the autosomes (i.e., the human chromosomes 1-22) in which a trait manifests in individuals with two pathogenic alleles, either homozygotes (two copies of the same mutant allele) or compound heterozygotes (whereby each copy of a gene has a distinct mutant allele). Evidence: TAS. (OMIM:608264)
- Prelingual sensorineural hearing impairment (HP:0000399): A form of sensorineural deafness with either congenital onset or infantile onset, i.e., before the acquisition of speech. Evidence: TAS. (OMIM:608264)
These phenotypes are associated with the disease autosomal recessive nonsyndromic hearing loss 40 (OMIM:608264).